Phenotypes associated with the disease colorectal cancer, hereditary nonpolyposis, type 7 (OMIM:614385):
- Hereditary nonpolyposis colorectal carcinoma (HP:0006716). Evidence: TAS. (OMIM:614385)
- Autosomal dominant inheritance (HP:0000006): A mode of inheritance that is observed for traits related to a gene encoded on one of the autosomes (i.e., the human chromosomes 1-22) in which a trait manifests in heterozygotes. In the context of medical genetics, an autosomal dominant disorder is caused when a single copy of the mutant allele is present. Males and females are affected equally, and can both transmit the disorder with a risk of 50% for each child of inheriting the mutant allele. Evidence: TAS. (OMIM:614385)